- Abnormality of the musculature (HP:0003011): Abnormality originating in one or more muscles, i.e., of the set of muscles of body. Evidence: IEA. (OMIM:261400)
- Foot dorsiflexor weakness (HP:0009027): Weakness of the muscles responsible for dorsiflexion of the foot, that is, of the movement of the toes towards the shin. The foot dorsiflexors include the tibialis anterior, the extensor hallucis longus, the extensor digitorum longus, and the peroneus tertius muscles. Evidence: TAS. (OMIM:261400)
- Autosomal recessive inheritance (HP:0000007): A mode of inheritance that is observed for traits related to a gene encoded on one of the autosomes (i.e., the human chromosomes 1-22) in which a trait manifests in individuals with two pathogenic alleles, either homozygotes (two copies of the same mutant allele) or compound heterozygotes (whereby each copy of a gene has a distinct mutant allele). Evidence: TAS. (OMIM:261400)
These phenotypes are associated with the disease peroneus tertius muscle, absence of (OMIM:261400).